- Atypical behavior (HP:0000708): Atypical behavior is an abnormality in a person's actions that can be controlled or modulated by the will of the individual. While abnormal behaviors can be difficult to control, they are distinct from other abnormal actions that cannot be affected by the individual's will. Evidence: TAS. Frequency: Very frequent (HP:0040281). (ORPHA:280397)
- Emotional lability (HP:0000712): Unstable emotional experiences and frequent mood changes; emotions that are easily aroused, intense, and/or disproportionate to events and circumstances. Evidence: TAS. Frequency: Very frequent (HP:0040281). (ORPHA:280397)
- Depression (HP:0000716): Frequently experiencing feelings of being down, miserable, and/or hopeless; struggling to recover from these moods; having a pessimistic outlook on the future; feeling a pervasive sense of shame; having a low self-worth; experiencing thoughts of suicide and engaging in suicidal behavior. Evidence: TAS. Frequency: Very frequent (HP:0040281). (ORPHA:280397)
- Anxiety (HP:0000739): Intense feelings of nervousness, tension, or panic often arise in response to interpersonal stresses. There is worry about the negative effects of past unpleasant experiences and future negative possibilities. Individuals may feel fearful, apprehensive, or threatened by uncertainty, and they may also have fears of falling apart or losing control. Evidence: TAS. Frequency: Very frequent (HP:0040281). (ORPHA:280397)
- Specific learning disability (HP:0001328): Impairment of certain skills such as reading or writing, coordination, self-control, or attention that interfere with the ability to learn. The impairment is not related to a global deficiency of intelligence. Evidence: TAS. Frequency: Very frequent (HP:0040281). (ORPHA:280397)
- Sleep disturbance (HP:0002360): An abnormal pattern in the quality, quantity, or characteristics of sleep. Evidence: TAS. Frequency: Very frequent (HP:0040281). (ORPHA:280397)
- Deficit in phonologic short-term memory (HP:0002549): Impaired ability to repeat non-word sounds. The test for nonword repetition involves the repetition of nonsensical words of increasing length and complexity and is regarded as a measure of phonological (speech sound) processing and short-term memory. Evidence: TAS. Frequency: Very frequent (HP:0040281). (ORPHA:280397)
- Attention deficit hyperactivity disorder (HP:0007018): Attention deficit hyperactivity disorder (ADHD) manifests at age 2-3 years or by first grade at the latest. The main symptoms are distractibility, impulsivity, hyperactivity, and often trouble organizing tasks and projects, difficulty going to sleep, and social problems from being aggressive, loud, or impatient. Evidence: TAS. Frequency: Very frequent (HP:0040281). (ORPHA:280397)
- Abdominal symptom (HP:0011458): A subjective manifestation of disease localized to the abdomen. Evidence: TAS. Frequency: Very frequent (HP:0040281). (ORPHA:280397)
- Perseverative thought (HP:0030223): The repetitive production of the same response to different commands. Evidence: TAS. Frequency: Very frequent (HP:0040281). (ORPHA:280397)
- Jaw pain (HP:0040264): An unpleasant sensation characterized by physical discomfort (such as pricking, throbbing, or aching) localized to the jaw. Evidence: TAS. Frequency: Very frequent (HP:0040281). (ORPHA:280397)
- Cognitive impairment (HP:0100543): Abnormal cognition is characterized by deficits in thinking, reasoning, or remembering. Evidence: TAS. Frequency: Very frequent (HP:0040281). (ORPHA:280397)
These phenotypes are associated with the disease Familial Alzheimer-like prion disease (ORPHA:280397).